- Bilateral tonic-clonic seizure on awakening (HP:0007193): Bilateral tonic-clonic seizure of either generalized or focal onset occurring on or soon after wakening (typically within 90 minutes of waking, regardless of the time of day). Evidence: TAS. (OMIM:607628)
- Generalized myoclonic seizure (HP:0002123): A generalized myoclonic seizure is a type of generalized motor seizure characterized by bilateral, sudden, brief (<100 ms) involuntary single or multiple contraction of muscles or muscle groups of variable topography (axial, proximal limb, distal). Myoclonus is less regularly repetitive and less sustained than is clonus. Evidence: TAS. Frequency: Occasional (HP:0040283). (OMIM:607628)
- Generalized non-motor (absence) seizure (HP:0002121): A generalized non-motor (absence) seizure is a type of a type of dialeptic seizure that is of electrographically generalized onset. It is a generalized seizure characterized by an interruption of activities, a blank stare, and usually the person will be unresponsive when spoken to. Any ictal motor phenomena are minor in comparison to these non-motor features. Evidence: TAS. Frequency: Occasional (HP:0040283). (OMIM:607628)
- Autosomal dominant inheritance (HP:0000006): A mode of inheritance that is observed for traits related to a gene encoded on one of the autosomes (i.e., the human chromosomes 1-22) in which a trait manifests in heterozygotes. In the context of medical genetics, an autosomal dominant disorder is caused when a single copy of the mutant allele is present. Males and females are affected equally, and can both transmit the disorder with a risk of 50% for each child of inheriting the mutant allele. Evidence: TAS. (OMIM:607628)
These phenotypes are associated with the disease epilepsy, idiopathic generalized, susceptibility to, 11 (OMIM:607628).